Phenotypes associated with the disease Pudendal nerve entrapment syndrome (ORPHA:60039):
- Allodynia (HP:0012533): Pain due to a stimulus that does not normally provoke pain. Evidence: TAS. Frequency: Very frequent (HP:0040281). (ORPHA:60039)
- Dyspareunia (HP:0030016): Recurrent or persistent genital pain associated with sexual intercourse. Evidence: TAS. Frequency: Very frequent (HP:0040281). (ORPHA:60039)
- Scrotal pain (HP:0030155): An unpleasant sensation characterized by physical discomfort (such as pricking, throbbing, or aching) localized to the scrotum. Evidence: TAS. Frequency: Very frequent (HP:0040281). (ORPHA:60039)
- Vulvodynia (HP:0030943): Pain in the vulvar area. Evidence: TAS. Frequency: Very frequent (HP:0040281). (ORPHA:60039)
- Paroxysmal rectal pain (HP:0032150): Excruciating burning pain in the rectal area that may be triggered by defecation. Evidence: TAS. Frequency: Very frequent (HP:0040281). (ORPHA:60039)
- Neuralgia (HP:0033345): Pain (An unpleasant sensory and emotional experience) along the course of a nerve. Evidence: TAS. Frequency: Very frequent (HP:0040281). (ORPHA:60039)
- Pollakisuria (HP:0100515): Increased frequency of urination. Evidence: TAS. Frequency: Very frequent (HP:0040281). (ORPHA:60039)
- Dysuria (HP:0100518): Painful or difficult urination. Evidence: TAS. Frequency: Very frequent (HP:0040281). (ORPHA:60039)
- Erectile dysfunction (HP:0100639): A multidimensional but common male sexual dysfunction that involves an alteration in any of the components of the erectile response, including organic, relational and psychological. Evidence: TAS. Frequency: Very frequent (HP:0040281). (ORPHA:60039)
- Anal pain (HP:0500005): Pain in and around the anus or rectum (perianal region). Evidence: TAS. Frequency: Very frequent (HP:0040281). (ORPHA:60039)
- Pelvic pain (HP:0034267): Pain perceived in the area of the pelvis, the lower part of the abdomen located between the hip bones. Evidence: TAS. Frequency: Frequent (HP:0040282). (ORPHA:60039)
- Buttock pain (HP:0034805): An unpleasant sensation characterized by physical discomfort (such as pricking, throbbing, or aching) localized to the buttock (round fleshy area at the lower rear area of a human trunk). Evidence: TAS. Frequency: Frequent (HP:0040282). (ORPHA:60039)
- Vaginal foreign body sensation (HP:0034806): A perception that an object located in the vagina. Evidence: TAS. Frequency: Frequent (HP:0040282). (ORPHA:60039)
Not associated with this disease:
- Pruritus (HP:0000989): Pruritus is an itch or a sensation that makes a person want to scratch. This term refers to an abnormally increased disposition to experience pruritus. Evidence: TAS. (ORPHA:60039)
- Abnormal nervous system electrophysiology (HP:0001311): An abnormality of the function of the electrical signals with which nerve cells communicate with each other or with muscles as measured by electrophysiological investigations. Evidence: TAS. (ORPHA:60039)
- Somatic sensory dysfunction (HP:0003474): An abnormality of the primary sensation that is mediated by peripheral nerves (pain, temperature, touch, vibration, joint position). The word hypoesthesia (or hypesthesia) refers to a reduction in cutaneous sensation to a specific type of testing. Evidence: TAS. (ORPHA:60039)
- Neoplasm of the genitourinary tract (HP:0007379): A tumor (abnormal growth of tissue) of the genitourinary system. Evidence: TAS. (ORPHA:60039)
- Genital neoplasm (HP:0010787): A tumor (abnormal growth of tissue) of the genital system. Evidence: TAS. (ORPHA:60039)
- Anal canal adenocarcinoma (HP:0030439): An adenoma carcinoma that originates in the anal canal. Evidence: TAS. (ORPHA:60039)